Phenotypes associated with the disease isolated congenital anosmia (OMIM:107200):
- Anosmia (HP:0000458): An inability to perceive odors. This is a general term describing inability to smell arising in any part of the process of smelling from absorption of odorants into the nasal mucous overlying the olfactory epithelium, diffusion to the cilia, binding to olfactory receptor sites, generation of action potentials in olfactory neurons, and perception of a smell. Evidence: TAS. Onset: Congenital onset (HP:0003577). (OMIM:107200)
- Autosomal dominant inheritance (HP:0000006): A mode of inheritance that is observed for traits related to a gene encoded on one of the autosomes (i.e., the human chromosomes 1-22) in which a trait manifests in heterozygotes. In the context of medical genetics, an autosomal dominant disorder is caused when a single copy of the mutant allele is present. Males and females are affected equally, and can both transmit the disorder with a risk of 50% for each child of inheriting the mutant allele. Evidence: IEA. (OMIM:107200)